- Cleft palate (HP:0000175): Cleft palate is a developmental defect of the palate resulting from a failure of fusion of the palatine processes and manifesting as a separation of the roof of the mouth (soft and hard palate). Evidence: IEA. (OMIM:183700)
- Toe syndactyly (HP:0001770): Webbing or fusion of the toes, involving soft parts only or including bone structure. Bony fusions are referred to as "bony" Syndactyly if the fusion occurs in a radio-ulnar axis. Fusions of bones of the toes in a proximo-distal axis are referred to as "Symphalangism". Evidence: IEA. (OMIM:183700)
- Mandibulofacial dysostosis (HP:0005321): A type of craniofacial dysostosis associated with abnormalities of the external ears, mirognathia, macrostomia, coloboma of the lower eyelid, and cleft palate. This is a bundled term that is left in the HPO now for convenience with legacy annotations but should not be used for new annotations. Evidence: IEA. (OMIM:183700)
- Malar flattening (HP:0000272): Underdevelopment of the malar prominence of the jugal bone (zygomatic bone in mammals), appreciated in profile, frontal view, and/or by palpation. Evidence: IEA. (OMIM:183700)
- Split foot (HP:0001839): A condition in which middle parts of the foot (toes and metatarsals) are missing giving a cleft appearance. The severity is very variable ranging from slightly hypoplastic 3rd toe over absent 2nd or 3rd toes as far as oligo- or monodactyl feet. Evidence: IEA. (OMIM:183700)
- Split hand (HP:0001171): A condition in which middle parts of the hand (fingers and metacarpals) are missing giving a cleft appearance. The severity is very variable ranging from slightly hypoplastic middle fingers over absent middle fingers as far as oligo- or monodactyl hands. Evidence: IEA. (OMIM:183700)
- Abnormality of the ear (HP:0000598): An abnormality of the ear. Evidence: IEA. (OMIM:183700)
- Micrognathia (HP:0000347): Developmental hypoplasia of the mandible. Evidence: IEA. (OMIM:183700)
- Autosomal dominant inheritance (HP:0000006): A mode of inheritance that is observed for traits related to a gene encoded on one of the autosomes (i.e., the human chromosomes 1-22) in which a trait manifests in heterozygotes. In the context of medical genetics, an autosomal dominant disorder is caused when a single copy of the mutant allele is present. Males and females are affected equally, and can both transmit the disorder with a risk of 50% for each child of inheriting the mutant allele. Evidence: TAS. (OMIM:183700)
These phenotypes are associated with the disease Patterson-Stevenson-Fontaine syndrome (OMIM:183700).